Phenotypes associated with the disease Worster-Drought syndrome (ORPHA:3465):
- Abnormal cranial nerve morphology (HP:0001291): Structural abnormality affecting one or more of the cranial nerves, which emerge directly from the brain stem. Evidence: TAS. Frequency: Very frequent (HP:0040281). (ORPHA:3465)
- Abnormal speech pattern (HP:0002167): An abnormality in the sound (volume) or cadence (rate) of speech. Evidence: TAS. Frequency: Very frequent (HP:0040281). (ORPHA:3465)
- Tongue muscle weakness (HP:0000183): Reduced strength of the tongue musculature, resulting in difficulties moving the tongue and possible accompanied by dysarthria or dysphagia. Evidence: TAS. Frequency: Frequent (HP:0040282). (ORPHA:3465)
- Specific learning disability (HP:0001328): Impairment of certain skills such as reading or writing, coordination, self-control, or attention that interfere with the ability to learn. The impairment is not related to a global deficiency of intelligence. Evidence: TAS. Frequency: Frequent (HP:0040282). (ORPHA:3465)
- Hyperreflexia (HP:0001347): Hyperreflexia is the presence of hyperactive stretch reflexes of the muscles. Evidence: TAS. Frequency: Frequent (HP:0040282). (ORPHA:3465)
- Dysphonia (HP:0001618): Difficulty in speaking due to a physical disorder of the mouth, tongue, throat, or vocal cords. Associated with a known physical or neurological cause. Evidence: TAS. Frequency: Frequent (HP:0040282). (ORPHA:3465)
- Dysphagia (HP:0002015): Difficulty in swallowing. Evidence: TAS. Frequency: Frequent (HP:0040282). (ORPHA:3465)
- Gastroesophageal reflux (HP:0002020): A condition in which the stomach contents leak backwards from the stomach into the esophagus through the lower esophageal sphincter. Evidence: TAS. Frequency: Frequent (HP:0040282). (ORPHA:3465)
- Recurrent respiratory infections (HP:0002205): An increased susceptibility to respiratory infections as manifested by a history of recurrent respiratory infections. Evidence: TAS. Frequency: Frequent (HP:0040282). (ORPHA:3465)
- Drooling (HP:0002307): Habitual flow of saliva out of the mouth. Evidence: TAS. Frequency: Frequent (HP:0040282). (ORPHA:3465)
- Tetraplegia (HP:0002445): Paralysis of all four limbs, and trunk of the body below the level of an associated injury to the spinal cord. The etiology of quadriplegia is similar to that of paraplegia except that the lesion is in the cervical spinal cord rather than in the thoracic or lumbar segments of the spinal cord. Evidence: TAS. Frequency: Occasional (HP:0040283). (ORPHA:3465)
- Jaw hyperreflexia (HP:0033683): Increased intensity of muscle tendon reflexes in jaw. Evidence: TAS. Frequency: Frequent (HP:0040282). (ORPHA:3465)
- Glue ear (HP:0040262): Middle ear is filled with glue-like fluid instead of air. Evidence: TAS. Frequency: Frequent (HP:0040282). (ORPHA:3465)
- Cognitive impairment (HP:0100543): Abnormal cognition is characterized by deficits in thinking, reasoning, or remembering. Evidence: TAS. Frequency: Frequent (HP:0040282). (ORPHA:3465)
- Microcephaly (HP:0000252): Head circumference below 2 standard deviations below the mean for age and gender. Evidence: TAS. Frequency: Occasional (HP:0040283). (ORPHA:3465)
- Sensorineural hearing impairment (HP:0000407): A type of hearing impairment in one or both ears related to an abnormal functionality of the cochlear nerve. Evidence: TAS. Frequency: Occasional (HP:0040283). (ORPHA:3465)
- Seizure (HP:0001250): A seizure is an intermittent abnormality of nervous system physiology characterized by a transient occurrence of signs and/or symptoms due to abnormal excessive or synchronous neuronal activity in the brain. Evidence: TAS. Frequency: Occasional (HP:0040283). (ORPHA:3465)
- Attention deficit hyperactivity disorder (HP:0007018): Attention deficit hyperactivity disorder (ADHD) manifests at age 2-3 years or by first grade at the latest. The main symptoms are distractibility, impulsivity, hyperactivity, and often trouble organizing tasks and projects, difficulty going to sleep, and social problems from being aggressive, loud, or impatient. Evidence: TAS. Frequency: Occasional (HP:0040283). (ORPHA:3465)